Phenotypes associated with the disease omphalocele, X-linked (OMIM:310980):
- Congenital onset (HP:0003577): A phenotypic abnormality that is present at birth. Evidence: TAS. (OMIM:310980)
- Omphalocele (HP:0001539): A midline anterior incomplete closure of the abdominal wall in which there is herniation of the abdominal viscera into the base of the abdominal cord. Evidence: IEA. (OMIM:310980)
- X-linked inheritance (HP:0001417): A mode of inheritance that is observed for traits related to a gene encoded on the X chromosome. Evidence: IEA. (OMIM:310980)